- Reduced leukocyte alkaline phosphatase (HP:0004852): Decreased alkaline phosphatase measured within leukocytes. Evidence: IEA. (OMIM:254700)
- Autosomal recessive inheritance (HP:0000007): A mode of inheritance that is observed for traits related to a gene encoded on one of the autosomes (i.e., the human chromosomes 1-22) in which a trait manifests in individuals with two pathogenic alleles, either homozygotes (two copies of the same mutant allele) or compound heterozygotes (whereby each copy of a gene has a distinct mutant allele). Evidence: IEA. (OMIM:254700)
- Myeloproliferative disorder (HP:0005547): Proliferation (excess production) of hemopoietically active tissue or of tissue which has embryonic hemopoietic potential. Evidence: IEA. (OMIM:254700)
These phenotypes are associated with the disease myeloproliferative disease, autosomal recessive (OMIM:254700).